Phenotypes associated with the disease teeth present at birth (OMIM:187050):
- Natal tooth (HP:0000695): A tooth present at birth or erupting within the first month of life. Evidence: IEA. (OMIM:187050)
- Autosomal dominant inheritance (HP:0000006): A mode of inheritance that is observed for traits related to a gene encoded on one of the autosomes (i.e., the human chromosomes 1-22) in which a trait manifests in heterozygotes. In the context of medical genetics, an autosomal dominant disorder is caused when a single copy of the mutant allele is present. Males and females are affected equally, and can both transmit the disorder with a risk of 50% for each child of inheriting the mutant allele. Evidence: IEA. (OMIM:187050)